- Late onset (HP:0003584): A type of adult onset with onset of symptoms after the age of 60 years. Evidence: PCS. Frequency: 9/9. (PMID:9497262)
- Reduced visual acuity (HP:0007663). Evidence: TAS. (OMIM:608471)
- Visual impairment (HP:0000505): Visual impairment (or vision impairment) is vision loss (of a person) to such a degree as to qualify as an additional support need through a significant limitation of visual capability resulting from either disease, trauma, or congenital or degenerative conditions that cannot be corrected by conventional means, such as refractive correction, medication, or surgery. Evidence: IEA. (OMIM:608471)
- Autosomal dominant inheritance (HP:0000006): A mode of inheritance that is observed for traits related to a gene encoded on one of the autosomes (i.e., the human chromosomes 1-22) in which a trait manifests in heterozygotes. In the context of medical genetics, an autosomal dominant disorder is caused when a single copy of the mutant allele is present. Males and females are affected equally, and can both transmit the disorder with a risk of 50% for each child of inheriting the mutant allele. Evidence: PCS. (PMID:9497262)
- Corneal erosion (HP:0200020): An erosion or abrasion of the cornea's outermost layer of epithelial cells. Evidence: TAS. (OMIM:608471)
- Lattice corneal dystrophy (HP:0001149): The presence of fine, branching linear opacities in Bowman's layer in the central area that may spread to the periphery in the clinical course. The deep corneal stroma may be involved but the process does not reach Descemet's membrane. Recurrent corneal erosion may occur. Histologic examination reveals amyloid deposits in the collagen fibers of the cornea. Evidence: PCS. Frequency: 9/9. (PMID:9497262)
These phenotypes are associated with the disease corneal dystrophy, lattice type 3A (OMIM:608471).